Phenotypes associated with the disease advanced sleep phase syndrome 2 (OMIM:615224):
- Sleep-wake cycle disturbance (HP:0006979): Any abnormality of an individual's circadian rhythm that affects the timing of sleeping and being awake is referred to as a sleep-wake disorder. Evidence: PCS. (PMID:15800623)
- Migraine (HP:0002076): Migraine is a chronic neurological disorder characterized by episodic attacks of headache and associated symptoms. Evidence: PCS. Frequency: 20/20. (OMIM:615224;PMID:23636092)
- Migraine with aura (HP:0002077): A type of migraine in which there is an aura characterized by focal neurological phenomena that usually proceed, but may accompany or occur in the absence of, the headache. The symptoms of an aura may include fully reversible visual, sensory, and speech symptoms but not motor weakness. Visual symptoms may include flickering lights, spots and lines and/or loss of vision and/or unilateral sensory symptoms such as paresthesias or numbness. At least one of the symptoms of an aura develops gradually over 5 or more minutes and/or different symptoms occur in succession. Evidence: PCS. (PMID:23636092)
- Migraine without aura (HP:0002083): Repeated headache attacks lasting 4-72 h fulfilling at least two of the following criteria: 1) unilateral location, 2) pulsating quality, 3) moderate or severe pain intensity, and 4) aggravation by or causing avoidance of routine physical activity such as climbing stairs. Headache attacks are commonly accompanied by nausea, vomiting, photophobia, or phonophobia. Evidence: PCS. (PMID:23636092)
- Early chronotype (HP:0031873): A tendency towards rising very early in the morning and going to bed early in the evening. Evidence: IEA. (OMIM:615224)
- Autosomal dominant inheritance (HP:0000006): A mode of inheritance that is observed for traits related to a gene encoded on one of the autosomes (i.e., the human chromosomes 1-22) in which a trait manifests in heterozygotes. In the context of medical genetics, an autosomal dominant disorder is caused when a single copy of the mutant allele is present. Males and females are affected equally, and can both transmit the disorder with a risk of 50% for each child of inheriting the mutant allele. Evidence: TAS. (OMIM:615224)